Phenotypes associated with the disease Graham Little-Piccardi-Lassueur syndrome (ORPHA:505):
- Pruritus (HP:0000989): Pruritus is an itch or a sensation that makes a person want to scratch. This term refers to an abnormally increased disposition to experience pruritus. Evidence: TAS. Frequency: Frequent (HP:0040282). (ORPHA:505)
- Alopecia (HP:0001596): A noncongenital process of hair loss, which may progress to partial or complete baldness. Evidence: TAS. Frequency: Very frequent (HP:0040281). (ORPHA:505)
- Sparse scalp hair (HP:0002209): Decreased number of hairs per unit area of skin of the scalp. Evidence: TAS. Frequency: Very frequent (HP:0040281). (ORPHA:505)
- Sparse axillary hair (HP:0002215): Reduced number or density of axillary hair. Evidence: TAS. Frequency: Very frequent (HP:0040281). (ORPHA:505)
- Sparse pubic hair (HP:0002225): Reduced number or density of pubic hair. Evidence: TAS. Frequency: Very frequent (HP:0040281). (ORPHA:505)
- Perifollicular hyperkeratosis (HP:0007468): Increased amount of keratin (visible as white scales) surrounding hair follicles. Evidence: TAS. Frequency: Very frequent (HP:0040281). (ORPHA:505)
- Lichenification (HP:0100725): Thickening and hardening of the epidermis seen with exaggeration of normal skin lines. Evidence: TAS. Frequency: Frequent (HP:0040282). (ORPHA:505)